- Abnormality of the nervous system (HP:0000707): An abnormality of the nervous system. Evidence: IEA. (OMIM:126180)
- Autosomal dominant inheritance (HP:0000006): A mode of inheritance that is observed for traits related to a gene encoded on one of the autosomes (i.e., the human chromosomes 1-22) in which a trait manifests in heterozygotes. In the context of medical genetics, an autosomal dominant disorder is caused when a single copy of the mutant allele is present. Males and females are affected equally, and can both transmit the disorder with a risk of 50% for each child of inheriting the mutant allele. Evidence: IEA. (OMIM:126180)
These phenotypes are associated with the disease discrimination, Two-point, reduction 1N (OMIM:126180).